Phenotypes associated with the disease lymphoma, non-Hodgkin, familial (OMIM:605027):
- Lymphoma (HP:0002665): A cancer originating in lymphocytes and presenting as a solid tumor of lymhpoid cells. Evidence: IEA. (OMIM:605027)